- Epicanthus (HP:0000286): A fold of skin starting above the medial aspect of the upper eyelid and arching downward to cover, pass in front of and lateral to the medial canthus. Evidence: PCS. Frequency: 1/1. (PMID:16283679)
- Upslanted palpebral fissure (HP:0000582): The palpebral fissure inclination is more than two standard deviations above the mean for age (objective); or, the inclination of the palpebral fissure is greater than typical for age. Evidence: PCS. Frequency: 1/1. (PMID:16283679)
- Long philtrum (HP:0000343): Distance between nasal base and midline upper lip vermilion border more than 2 SD above the mean. Alternatively, an apparently increased distance between nasal base and midline upper lip vermilion border. Evidence: PCS. Frequency: 1/1. (PMID:16283679)
- Strabismus (HP:0000486): A misalignment of the eyes so that the visual axes deviate from bifoveal fixation. The classification of strabismus may be based on a number of features including the relative position of the eyes, whether the deviation is latent or manifest, intermittent or constant, concomitant or otherwise and according to the age of onset and the relevance of any associated refractive error. Evidence: PCS. Frequency: 1/1. (PMID:16283679)
- Trigonocephaly (HP:0000243): Wedge-shaped, or triangular head, with the apex of the triangle at the midline of the forehead and the base of the triangle at the occiput. Evidence: PCS. Frequency: 1/1. (PMID:16283679)
- Anteverted nares (HP:0000463): Anteriorly-facing nostrils viewed with the head in the Frankfurt horizontal and the eyes of the observer level with the eyes of the subject. This gives the appearance of an upturned nose (upturned nasal tip). Evidence: PCS. Frequency: 1/1. (PMID:16283679)
- Hypotonia (HP:0001252): Hypotonia is an abnormally low muscle tone (the amount of tension or resistance to movement in a muscle). Even when relaxed, muscles have a continuous and passive partial contraction which provides some resistance to passive stretching. Hypotonia thus manifests as diminished resistance to passive stretching. Hypotonia is not the same as muscle weakness, although the two conditions can co-exist. Evidence: PCS. Frequency: 1/1. (PMID:16283679)
- Short nose (HP:0003196): Distance from nasion to subnasale more than two standard deviations below the mean, or alternatively, an apparently decreased length from the nasal root to the nasal tip. Evidence: PCS. Frequency: 1/1. (PMID:16283679)
- Depressed nasal bridge (HP:0005280): Posterior positioning of the nasal root in relation to the overall facial profile for age. Evidence: PCS. Frequency: 1/1. (PMID:16283679)
- Happy demeanor (HP:0040082): A conspicuously happy disposition, characterized by frequent smiling and laughing, which may be contextually inappropriate or unrelated to the situation. Evidence: PCS. Frequency: 1/1. (PMID:16283679)
- Metopic synostosis (HP:0011330): Premature fusion of the metopic suture. Evidence: PCS. Frequency: 1/1. (PMID:16283679)
- Chronic constipation (HP:0012450): Constipation for longer than three months with fewer than 3 bowel movements per week, straining, lumpy or hard stools, and a sensation of anorectal obstruction or incomplete defecation. Evidence: PCS. Frequency: 1/1. (PMID:16283679)
- X-linked inheritance (HP:0001417): A mode of inheritance that is observed for traits related to a gene encoded on the X chromosome. Evidence: PCS. (PMID:16283679)
- Hypospadias (HP:0000047): Abnormal position of urethral meatus on the ventral penile shaft (underside) characterized by displacement of the urethral meatus from the tip of the glans penis to the ventral surface of the penis, scrotum, or perineum. Evidence: PCS. Frequency: 1/1. (PMID:16283679)
- Diastema (HP:0000699): Increased space between two adjacent teeth in the same dental arch. Evidence: PCS. Frequency: 1/1. (PMID:16283679)
- Neonatal onset (HP:0003623): Onset of signs or symptoms of disease within the first 28 days of life. Evidence: PCS. Frequency: 1/1. (PMID:16283679)
These phenotypes are associated with the disease FG syndrome 5 (OMIM:300581).